Phenotypes associated with the disease cataract 14 multiple types (OMIM:601885):
- Zonular cataract (HP:0010920): Zonular cataracts are defined to be cataracts that affect specific regions of the lens. Evidence: IEA. (OMIM:601885)
- Autosomal dominant inheritance (HP:0000006): A mode of inheritance that is observed for traits related to a gene encoded on one of the autosomes (i.e., the human chromosomes 1-22) in which a trait manifests in heterozygotes. In the context of medical genetics, an autosomal dominant disorder is caused when a single copy of the mutant allele is present. Males and females are affected equally, and can both transmit the disorder with a risk of 50% for each child of inheriting the mutant allele. Evidence: IEA. (OMIM:601885)